Phenotypes associated with the disease retinitis pigmentosa 46 (OMIM:612572):
- Constriction of peripheral visual field (HP:0001133): An absolute or relative decrease in retinal sensitivity extending from edge (periphery) of the visual field in a concentric pattern. The visual field is the area that is perceived simultaneously by a fixating eye. Evidence: PCS. Frequency: 2/2. (PMID:18806796)
- Pigmentary retinopathy (HP:0000580): An abnormality of the retina characterized by pigment deposition. It is typically associated with migration and proliferation of macrophages or retinal pigment epithelial cells into the retina; melanin from these cells causes the pigmentary changes. Pigmentary retinopathy is a common final pathway of many retinal conditions and is often associated with visual loss. Evidence: PCS. Frequency: 2/2. (PMID:18806796)
- Autosomal recessive inheritance (HP:0000007): A mode of inheritance that is observed for traits related to a gene encoded on one of the autosomes (i.e., the human chromosomes 1-22) in which a trait manifests in individuals with two pathogenic alleles, either homozygotes (two copies of the same mutant allele) or compound heterozygotes (whereby each copy of a gene has a distinct mutant allele). Evidence: PCS. (PMID:18806796)
- Visual impairment (HP:0000505): Visual impairment (or vision impairment) is vision loss (of a person) to such a degree as to qualify as an additional support need through a significant limitation of visual capability resulting from either disease, trauma, or congenital or degenerative conditions that cannot be corrected by conventional means, such as refractive correction, medication, or surgery. Evidence: PCS. Frequency: 2/2. (PMID:18806796)
- Rod-cone dystrophy (HP:0000510): An inherited retinal disease subtype in which the rod photoreceptors appear to be more severely affected than the cone photoreceptors. Typical presentation is with nyctalopia (due to rod dysfunction) followed by loss of mid-peripheral field of vision, which gradually extends and leaves many patients with a small central island of vision due to the preservation of macular cones. Evidence: PCS. Frequency: 2/2. (PMID:18806796)
- Optic disc pallor (HP:0000543): A pale yellow discoloration of the optic disc (the area of the optic nerve head in the retina). The optic disc normally has a pinkish hue with a central yellowish depression. Evidence: PCS. Frequency: 2/2. (PMID:18806796)
- Posterior subcapsular cataract (HP:0007787): A type of cataract affecting the posterior pole of lens immediately adjacent to ('beneath') the Lens capsule. Evidence: PCS. Frequency: 1/2. (PMID:18806796)
- Attenuation of retinal blood vessels (HP:0007843): Narrowing of the retinal blood vessels, both arterioles and venules. Evidence: PCS. Frequency: 2/2. (PMID:18806796)
- Decreased light- and dark-adapted electroretinogram amplitude (HP:0000654): Decreased amplitude of eletrical response upon electroretinography. Evidence: PCS. Frequency: 2/2. (PMID:18806796)